- Depression (HP:0000716): Frequently experiencing feelings of being down, miserable, and/or hopeless; struggling to recover from these moods; having a pessimistic outlook on the future; feeling a pervasive sense of shame; having a low self-worth; experiencing thoughts of suicide and engaging in suicidal behavior. Evidence: TAS. Frequency: Frequent (HP:0040282). (ORPHA:221098)
- Anxiety (HP:0000739): Intense feelings of nervousness, tension, or panic often arise in response to interpersonal stresses. There is worry about the negative effects of past unpleasant experiences and future negative possibilities. Individuals may feel fearful, apprehensive, or threatened by uncertainty, and they may also have fears of falling apart or losing control. Evidence: TAS. Frequency: Frequent (HP:0040282). (ORPHA:221098)
- Cranial nerve compression (HP:0001293). Evidence: TAS. Frequency: Frequent (HP:0040282). (ORPHA:221098)
- Jaw claudication (HP:0030164): Pain in the jaw or ear induced by chewing or otherwise moving the jaw. Evidence: TAS. Frequency: Frequent (HP:0040282). (ORPHA:221098)
- Ear pain (HP:0030766): Pain in the ear can be a consequence of otologic disease (primary or otogenic otalgia), or can arise from pathologic processes and structures other than the ear (secondary or referred otalgia). Evidence: TAS. Frequency: Frequent (HP:0040282). (ORPHA:221098)
- Tongue pain (HP:0030811): An unpleasant sensation characterized by physical discomfort (such as pricking, throbbing, or aching) localized to the tongue. Evidence: TAS. Frequency: Frequent (HP:0040282). (ORPHA:221098)
- Episodic pain (HP:0032148): Intermittent pain, i.e., pain that occurs occasionally and at irregular intervals. Evidence: TAS. Frequency: Frequent (HP:0040282). (ORPHA:221098)
- Mandibular pain (HP:0200025): An unpleasant sensation characterized by physical discomfort (such as pricking, throbbing, or aching) localized to the mandible. Evidence: TAS. Frequency: Frequent (HP:0040282). (ORPHA:221098)
- Abnormal glossopharyngeal nerve morphology (HP:3000047): Any structural anomaly of the glossopharyngeal nerve, the ninth paired cranial nerve (CN IX). Evidence: TAS. Frequency: Frequent (HP:0040282). (ORPHA:221098)
- Abnormal palate morphology (HP:0000174): Any abnormality of the palate, i.e., of roof of the mouth. Evidence: TAS. Frequency: Occasional (HP:0040283). (ORPHA:221098)
- Seizure (HP:0001250): A seizure is an intermittent abnormality of nervous system physiology characterized by a transient occurrence of signs and/or symptoms due to abnormal excessive or synchronous neuronal activity in the brain. Evidence: TAS. Frequency: Occasional (HP:0040283). (ORPHA:221098)
- Syncope (HP:0001279): A transient loss of consciousness (i.e., characterized by a rapid onset, a short duration, and a spontaneous and complete recovery) due to cerebral hypoperfusion. Evidence: TAS. Frequency: Occasional (HP:0040283). (ORPHA:221098)
- Vocal cord paralysis (HP:0001605): A loss of the ability to move the vocal folds. Evidence: TAS. Frequency: Occasional (HP:0040283). (ORPHA:221098)
- Hoarse voice (HP:0001609): Hoarseness refers to a change in the pitch or quality of the voice, with the voice sounding weak, very breathy, scratchy, or husky. Evidence: TAS. Frequency: Occasional (HP:0040283). (ORPHA:221098)
- Bradycardia (HP:0001662): A slower than normal heart rate (in adults, slower than 60 beats per minute). Evidence: TAS. Frequency: Occasional (HP:0040283). (ORPHA:221098)
- Weight loss (HP:0001824): Reduction of total body weight. Evidence: TAS. Frequency: Occasional (HP:0040283). (ORPHA:221098)
- Headache (HP:0002315): Cephalgia, or pain sensed in various parts of the head, not confined to the area of distribution of any nerve. Evidence: TAS. Frequency: Occasional (HP:0040283). (ORPHA:221098)
- Vascular dilatation (HP:0002617): An abnormal increase in the diameter of an artery or vein, either as a diffuse dilatation or as a localized, sac-like outpouching of the vessel wall (aneurysm). Evidence: TAS. Frequency: Occasional (HP:0040283). (ORPHA:221098)
- Neoplasm (HP:0002664): An organ or organ-system abnormality that consists of uncontrolled autonomous cell-proliferation which can occur in any part of the body as a benign or malignant neoplasm (tumor). Evidence: TAS. Frequency: Occasional (HP:0040283). (ORPHA:221098)
- Autoimmunity (HP:0002960): The occurrence of an immune reaction against the organism's own cells or tissues. Evidence: TAS. Frequency: Occasional (HP:0040283). (ORPHA:221098)
- Abnormality of the cervical spine (HP:0003319): Any abnormality of the cervical vertebral column. Evidence: TAS. Frequency: Occasional (HP:0040283). (ORPHA:221098)
- Malnutrition (HP:0004395): A deficiency in the intake of energy and nutrients. Evidence: TAS. Frequency: Occasional (HP:0040283). (ORPHA:221098)
- Chiari type I malformation (HP:0007099): Arnold-Chiari type I malformation refers to a relatively mild degree of herniation of the posteroinferior region of the cerebellum (the cerebellar tonsils) into the cervical canal with little or no displacement of the fourth ventricle. It is characterized by one or both pointed (not rounded) cerebellar tonsils that project 5 mm below the foramen magnum, measured by a line drawn from the basion to the opisthion (McRae Line). Evidence: TAS. Frequency: Occasional (HP:0040283). (ORPHA:221098)
- Feeding difficulties (HP:0011968): Impaired ability to eat related to problems gathering food and getting ready to suck, chew, or swallow it. Evidence: TAS. Frequency: Occasional (HP:0040283). (ORPHA:221098)
- Dysesthesia (HP:0012534): Painful sensations elicited by a nonpainful cutaneous stimulus such as a light touch or gentle stroking over affected areas of the body. Sometimes referred to as hyperpathia or hyperalgesia. Often perceived as an intense burning, dyesthesias may outlast the stimulus by several seconds. Evidence: TAS. Frequency: Occasional (HP:0040283). (ORPHA:221098)
- Odynophagia (HP:0032043): Pain experienced with swallowing. Evidence: TAS. Frequency: Occasional (HP:0040283). (ORPHA:221098)
- Schwannoma (HP:0100008): A benign nerve sheath tumor composed of Schwann cells. Evidence: TAS. Frequency: Occasional (HP:0040283). (ORPHA:221098)
- Oral-pharyngeal dysphagia (HP:0200136). Evidence: TAS. Frequency: Occasional (HP:0040283). (ORPHA:221098)
These phenotypes are associated with the disease Glossopharyngeal neuralgia (ORPHA:221098).